Phenotypes associated with the disease Hall-Riggs syndrome (ORPHA:2107):
- Wide mouth (HP:0000154): Distance between the oral commissures more than 2 SD above the mean. Alternatively, an apparently increased width of the oral aperture (subjective). Evidence: TAS. Frequency: Frequent (HP:0040282). (ORPHA:2107)
- Microcephaly (HP:0000252): Head circumference below 2 standard deviations below the mean for age and gender. Evidence: TAS. Frequency: Very frequent (HP:0040281). (ORPHA:2107)
- Epicanthus (HP:0000286): A fold of skin starting above the medial aspect of the upper eyelid and arching downward to cover, pass in front of and lateral to the medial canthus. Evidence: TAS. Frequency: Very frequent (HP:0040281). (ORPHA:2107)
- Hypertelorism (HP:0000316): Interpupillary distance more than 2 SD above the mean (alternatively, the appearance of an increased interpupillary distance or widely spaced eyes). Evidence: TAS. Frequency: Frequent (HP:0040282). (ORPHA:2107)
- Wide nasal bridge (HP:0000431): Increased breadth of the nasal bridge (and with it, the nasal root). Evidence: TAS. Frequency: Very frequent (HP:0040281). (ORPHA:2107)
- Prominent nose (HP:0000448): Distance between subnasale and pronasale more than two standard deviations above the mean, or alternatively, an apparently increased anterior protrusion of the nasal tip. Evidence: TAS. Frequency: Frequent (HP:0040282). (ORPHA:2107)
- Anteverted nares (HP:0000463): Anteriorly-facing nostrils viewed with the head in the Frankfurt horizontal and the eyes of the observer level with the eyes of the subject. This gives the appearance of an upturned nose (upturned nasal tip). Evidence: TAS. Frequency: Very frequent (HP:0040281). (ORPHA:2107)
- Abnormal dental enamel morphology (HP:0000682): An abnormality of the dental enamel. Evidence: TAS. Frequency: Occasional (HP:0040283). (ORPHA:2107)
- Delayed eruption of teeth (HP:0000684): Delayed tooth eruption, which can be defined as tooth eruption more than 2 SD beyond the mean eruption age. Evidence: TAS. Frequency: Occasional (HP:0040283). (ORPHA:2107)
- Platyspondyly (HP:0000926): A flattened vertebral body shape with reduced distance between the vertebral endplates. Evidence: TAS. Frequency: Frequent (HP:0040282). (ORPHA:2107)
- Abnormal metaphysis morphology (HP:0000944): An abnormality of one or more metaphysis, i.e., of the somewhat wider portion of a long bone that is adjacent to the epiphyseal growth plate and grows during childhood. Evidence: TAS. Frequency: Frequent (HP:0040282). (ORPHA:2107)
- Brachydactyly (HP:0001156): Digits that appear disproportionately short compared to the hand/foot. The word brachydactyly is used here to describe a series distinct patterns of shortened digits (brachydactyly types A-E). This is the sense used here. Evidence: TAS. Frequency: Frequent (HP:0040282). (ORPHA:2107)
- Seizure (HP:0001250): A seizure is an intermittent abnormality of nervous system physiology characterized by a transient occurrence of signs and/or symptoms due to abnormal excessive or synchronous neuronal activity in the brain. Evidence: TAS. Frequency: Frequent (HP:0040282). (ORPHA:2107)
- Absent speech (HP:0001344): Complete lack of development of speech and language abilities. Evidence: TAS. Frequency: Very frequent (HP:0040281). (ORPHA:2107)
- Joint stiffness (HP:0001387): Joint stiffness is a perceived sensation of tightness in a joint or joints when attempting to move them after a period of inactivity. Joint stiffness typically subsides over time. Evidence: TAS. Frequency: Occasional (HP:0040283). (ORPHA:2107)
- Failure to thrive (HP:0001508): Failure to thrive (FTT) refers to a child whose physical growth is substantially below the norm. Evidence: TAS. Frequency: Frequent (HP:0040282). (ORPHA:2107)
- Nausea and vomiting (HP:0002017): Nausea is a commonly encountered symptom that has been defined as an unpleasant painless subjective feeling that one will imminently vomit. Vomiting has been defined as the forceful expulsion of the contents of the stomach, duodenum, or jejunum through the oral cavity. While nausea and vomiting are often thought to exist on a temporal continuum, this is not always the case. There are situations when severe nausea may be present without emesis and less frequently, when emesis may be present without preceding nausea. Evidence: TAS. Frequency: Frequent (HP:0040282). (ORPHA:2107)
- Coarse hair (HP:0002208): Hair shafts are rough in texture. Evidence: TAS. Frequency: Frequent (HP:0040282). (ORPHA:2107)
- Slow-growing hair (HP:0002217): Hair whose growth is slower than normal. Evidence: TAS. Frequency: Frequent (HP:0040282). (ORPHA:2107)
- Scoliosis (HP:0002650): The presence of an abnormal lateral curvature of the spine. Evidence: TAS. Frequency: Frequent (HP:0040282). (ORPHA:2107)
- Downturned corners of mouth (HP:0002714): A morphological abnormality of the mouth in which the angle of the mouth is downturned. The oral commissures are positioned inferior to the midline labial fissure. Evidence: TAS. Frequency: Frequent (HP:0040282). (ORPHA:2107)
- Delayed skeletal maturation (HP:0002750): A decreased rate of skeletal maturation. Delayed skeletal maturation can be diagnosed on the basis of an estimation of the bone age from radiographs of specific bones in the human body. Evidence: TAS. Frequency: Frequent (HP:0040282). (ORPHA:2107)
- Short stature (HP:0004322): A height below that which is expected according to age and gender norms. Although there is no universally accepted definition of short stature, many refer to "short stature" as height more than 2 standard deviations below the mean for age and gender (or below the 3rd percentile for age and gender dependent norms). Evidence: TAS. Frequency: Very frequent (HP:0040281). (ORPHA:2107)
- Abnormal epiphysis morphology (HP:0005930): An anomaly of epiphysis, which is the expanded articular end of a long bone that developes from a secondary ossification center, and which during the period of growth is either entirely cartilaginous or is separated from the shaft by a cartilaginous disk. Evidence: TAS. Frequency: Frequent (HP:0040282). (ORPHA:2107)
- Limb undergrowth (HP:0009826): Limb shortening because of underdevelopment of one or more bones of the extremities. Evidence: TAS. Frequency: Frequent (HP:0040282). (ORPHA:2107)
- Severe intellectual disability (HP:0010864): Severe intellectual disability (ID) is defined as a type of ID characterized by severely sub-average adaptive functioning and intellectual functioning, with an intelligence quotient (IQ) the range of 20-34. Evidence: TAS. Frequency: Very frequent (HP:0040281). (ORPHA:2107)
- Severe global developmental delay (HP:0011344): A severe delay in the achievement of motor or mental milestones in the domains of development of a child. Evidence: TAS. Frequency: Very frequent (HP:0040281). (ORPHA:2107)
- Thick vermilion border (HP:0012471): Increased width of the skin of vermilion border region of upper lip. Evidence: TAS. Frequency: Very frequent (HP:0040281). (ORPHA:2107)
- Thick hair (HP:0100874): Increased density of hairs, i.e., and elevated number of hairs per unit area. Evidence: TAS. Frequency: Frequent (HP:0040282). (ORPHA:2107)